- Urinary incontinence (HP:0000020): Loss of the ability to control the urinary bladder leading to involuntary urination. Evidence: TAS. Frequency: Frequent (HP:0040282). (ORPHA:309263)
- Optic atrophy (HP:0000648): Atrophy of the optic nerve. Optic atrophy results from the death of the retinal ganglion cell axons that comprise the optic nerve and manifesting as a pale optic nerve on fundoscopy. Evidence: TAS. Frequency: Frequent (HP:0040282). (ORPHA:309263)
- Short attention span (HP:0000736): Reduced attention span characterized by distractibility and impulsivity. Evidence: TAS. Frequency: Frequent (HP:0040282). (ORPHA:309263)
- Decreased nerve conduction velocity (HP:0000762): A reduction in the speed at which electrical signals propagate along the axon of a neuron. Evidence: TAS. Frequency: Frequent (HP:0040282). (ORPHA:309263)
- Dysarthria (HP:0001260): Dysarthric speech is a general description referring to a neurological speech disorder characterized by poor articulation. Depending on the involved neurological structures, dysarthria may be further classified as spastic, flaccid, ataxic, hyperkinetic and hypokinetic, or mixed. Evidence: TAS. Frequency: Frequent (HP:0040282). (ORPHA:309263)
- Hyporeflexia (HP:0001265): Reduction of neurologic reflexes such as the knee-jerk reaction. Evidence: TAS. Frequency: Frequent (HP:0040282). (ORPHA:309263)
- Generalized hypotonia (HP:0001290): Generalized muscular hypotonia (abnormally low muscle tone). Evidence: TAS. Frequency: Frequent (HP:0040282). (ORPHA:309263)
- Muscle weakness (HP:0001324): Reduced strength of muscles. Evidence: TAS. Frequency: Frequent (HP:0040282). (ORPHA:309263)
- Dystonia (HP:0001332): An abnormally increased muscular tone that causes fixed abnormal postures. There is a slow, intermittent twisting motion that leads to exaggerated turning and posture of the extremities and trunk. Evidence: TAS. Frequency: Frequent (HP:0040282). (ORPHA:309263)
- Clumsiness (HP:0002312): Lack of physical coordination resulting in an abnormal tendency to drop items or bump into objects. Evidence: TAS. Frequency: Frequent (HP:0040282). (ORPHA:309263)
- Frequent falls (HP:0002359). Evidence: TAS. Frequency: Frequent (HP:0040282). (ORPHA:309263)
- Developmental regression (HP:0002376): Loss of developmental skills, as manifested by loss of developmental milestones. Evidence: TAS. Frequency: Frequent (HP:0040282). (ORPHA:309263)
- Leukodystrophy (HP:0002415): Leukodystrophy refers to deterioration of white matter of the brain resulting from degeneration of myelin sheaths in the CNS. Their basic defect is directly related to the synthesis and maintenance of myelin membranes. Symmetric white matter involvement at MRI is a typical finding in patients with leukodystrophies. Evidence: TAS. Frequency: Frequent (HP:0040282). (ORPHA:309263)
- Increased CSF protein concentration (HP:0002922): Increased concentration of protein in the cerebrospinal fluid. Evidence: TAS. Frequency: Frequent (HP:0040282). (ORPHA:309263)
- Abnormal glycosphingolipid metabolism (HP:0004343): An abnormality of glycosphingolipid metabolism. Evidence: TAS. Frequency: Frequent (HP:0040282). (ORPHA:309263)
- Abnormal social behavior (HP:0012433): An abnormality of actions or reactions of a person exhibited during social interactions with other individuals. Evidence: TAS. Frequency: Frequent (HP:0040282). (ORPHA:309263)
- Punctate periventricular T2 hyperintense foci (HP:0030081): Multiple pointlike areas of high T2 signal observed upon magnetic resonance imaging of the periventricular cerebral white matter. Evidence: TAS. Frequency: Frequent (HP:0040282). (ORPHA:309263)
- Abnormality of visual evoked potentials (HP:0000649): An anomaly of visually evoked potentials (VEP), which are electrical potentials, initiated by brief visual stimuli, which are recorded from the scalp overlying the visual cortex. Evidence: TAS. Frequency: Occasional (HP:0040283). (ORPHA:309263)
- Emotional lability (HP:0000712): Unstable emotional experiences and frequent mood changes; emotions that are easily aroused, intense, and/or disproportionate to events and circumstances. Evidence: TAS. Frequency: Occasional (HP:0040283). (ORPHA:309263)
- Hallucinations (HP:0000738): Perceptions in a conscious and awake state that, in the absence of external stimuli, have qualities of real perception. These perceptions are vivid, substantial, and located in external objective space. Evidence: TAS. Frequency: Occasional (HP:0040283). (ORPHA:309263)
- Delusion (HP:0000746): A delusion is a fixed false belief held despite evidence to the contrary. The term delusion broadly encompasses all false judgments that possess the following external characteristics to a significant, albeit unspecified, extent: (1) they are held with an exceptional level of conviction, accompanied by an unparalleled subjective certainty; (2) there is an inability to consider alternative experiences or compelling counter-arguments; (3) the content of the belief is impossible. Evidence: TAS. Frequency: Occasional (HP:0040283). (ORPHA:309263)
- Cholecystitis (HP:0001082): The presence of inflammatory changes in the gallbladder. Evidence: TAS. Frequency: Occasional (HP:0040283). (ORPHA:309263)
- Seizure (HP:0001250): A seizure is an intermittent abnormality of nervous system physiology characterized by a transient occurrence of signs and/or symptoms due to abnormal excessive or synchronous neuronal activity in the brain. Evidence: TAS. Frequency: Occasional (HP:0040283). (ORPHA:309263)
- Spasticity (HP:0001257): A motor disorder characterized by a velocity-dependent increase in tonic stretch reflexes with increased muscle tone, exaggerated (hyperexcitable) tendon reflexes. Evidence: TAS. Frequency: Occasional (HP:0040283). (ORPHA:309263)
- Abnormality of metabolism/homeostasis (HP:0001939). Evidence: TAS. Frequency: Occasional (HP:0040283). (ORPHA:309263)
- Intention tremor (HP:0002080): A type of kinetic tremor that occurs during target directed movement is called intention tremor. That is, an oscillatory cerebellar ataxia that tends to be absent when the limbs are inactive and during the first part of voluntary movement but worsening as the movement continues and greater precision is required (e.g., in touching a target such as the patient's nose or a physician's finger). Evidence: TAS. Frequency: Occasional (HP:0040283). (ORPHA:309263)
- Loss of speech (HP:0002371). Evidence: TAS. Frequency: Occasional (HP:0040283). (ORPHA:309263)
- Abdominal distention (HP:0003270): Distention of the abdomen. Evidence: TAS. Frequency: Occasional (HP:0040283). (ORPHA:309263)
- EMG: chronic denervation signs (HP:0003444): Evidence of chronic denervation on electromyography. Evidence: TAS. Frequency: Occasional (HP:0040283). (ORPHA:309263)
- Babinski sign (HP:0003487): Upturning of the big toe (and sometimes fanning of the other toes) in response to stimulation of the sole of the foot. If the Babinski sign is present it can indicate damage to the corticospinal tract. Evidence: TAS. Frequency: Occasional (HP:0040283). (ORPHA:309263)
- Progressive peripheral neuropathy (HP:0007133). Evidence: TAS. Frequency: Occasional (HP:0040283). (ORPHA:309263)
- Progressive gait ataxia (HP:0007240): A type of gait ataxia displaying progression of clinical severity. Evidence: TAS. Frequency: Occasional (HP:0040283). (ORPHA:309263)
- Progressive psychomotor deterioration (HP:0007272). Evidence: TAS. Frequency: Occasional (HP:0040283). (ORPHA:309263)
- Reduced visual acuity (HP:0007663). Evidence: TAS. Frequency: Occasional (HP:0040283). (ORPHA:309263)
- Bilateral sensorineural hearing impairment (HP:0008619): A form of sensorineural hearing impairment that affects both ears. Evidence: TAS. Frequency: Occasional (HP:0040283). (ORPHA:309263)
- Decerebrate rigidity (HP:0025013): A type of rigidity that is manifested by an exaggerated extensor posture of all extremities. Evidence: TAS. Frequency: Very rare (HP:0040284). (ORPHA:309263)
- Vegetative state (HP:0031358): The absence of wakefulness and consciousness, but in contrast to a coma, there is involuntary opening of the eyes and movements such as teeth grinding, yawning, or thrashing of the extremities. Evidence: TAS. Frequency: Very rare (HP:0040284). (ORPHA:309263)
These phenotypes are associated with the disease Metachromatic leukodystrophy, juvenile form (ORPHA:309263).